Phenotypes associated with the disease seizures, benign familial neonatal, 2 (OMIM:121201):
- Bilateral tonic-clonic seizure (HP:0002069): A bilateral tonic-clonic seizure is a seizure defined by a tonic (bilateral increased tone, lasting seconds to minutes) and then a clonic (bilateral sustained rhythmic jerking) phase. Evidence: PCS. Frequency: 1/7. Onset: Neonatal onset (HP:0003623). (PMID:9425900)
- Bilateral tonic-clonic seizure (HP:0002069): A bilateral tonic-clonic seizure is a seizure defined by a tonic (bilateral increased tone, lasting seconds to minutes) and then a clonic (bilateral sustained rhythmic jerking) phase. Evidence: PCS. Frequency: 0/15. (PMID:9425900)
- Focal clonic seizure (HP:0002266): A focal clonic seizure is a type of focal motor seizure characterized by sustained rhythmic jerking, that is regularly repetitive. Evidence: PCS. Frequency: 21/22. (PMID:9425900)
- Global developmental delay (HP:0001263): A delay in the achievement of motor or mental milestones in the domains of development of a child, including motor skills, speech and language, cognitive skills, and social and emotional skills. This term should only be used to describe children younger than five years of age. Evidence: PCS. Frequency: 0/15. (PMID:9425900)
- Autosomal dominant inheritance (HP:0000006): A mode of inheritance that is observed for traits related to a gene encoded on one of the autosomes (i.e., the human chromosomes 1-22) in which a trait manifests in heterozygotes. In the context of medical genetics, an autosomal dominant disorder is caused when a single copy of the mutant allele is present. Males and females are affected equally, and can both transmit the disorder with a risk of 50% for each child of inheriting the mutant allele. Evidence: PCS. (PMID:9425900)
- Intellectual disability (HP:0001249): The term intellectual disability or intellectual developmental disorder is used to describe significantly sub-average intellectual and adaptive functioning based on clinical assessment and as measured by individually administered, appropriately normed, standardized and validated tests of intellectual functioning and adaptive behavior, with onset during the developmental period from infancy through adolescence. Evidence: PCS. Frequency: 0/7. (PMID:9425900)
- Neonatal onset (HP:0003623): Onset of signs or symptoms of disease within the first 28 days of life. Evidence: PCS. Frequency: 21/21. (PMID:9425900)